- Long penis (HP:0000040): Penile length more than 2 SD above the mean for age. Evidence: TAS. Frequency: Frequent (HP:0040282). (ORPHA:2477)
- Macroorchidism (HP:0000053): The presence of abnormally large testes. Evidence: TAS. Frequency: Frequent (HP:0040282). (ORPHA:2477)
- Abnormal cranial suture/fontanelle morphology (HP:0000235): Any abnormality of the fontanelles (the regions covered by a thick membrane that normally ossify in the first two years of life) or the cranial sutures (the fibrous joints in which the articulating bones or cartilages of the skull are connected by sutural ligaments). Evidence: TAS. Frequency: Very frequent (HP:0040281). (ORPHA:2477)
- Macrocephaly (HP:0000256): Occipitofrontal (head) circumference greater than 97th centile compared to appropriate, age matched, sex-matched normal standards. Alternatively, a apparently increased size of the cranium. Evidence: TAS. Frequency: Very frequent (HP:0040281). (ORPHA:2477)
- Dolichocephaly (HP:0000268): An abnormality of skull shape characterized by a increased anterior-posterior diameter, i.e., an increased antero-posterior dimension of the skull. Cephalic index less than 76%. Alternatively, an apparently increased antero-posterior length of the head compared to width. Often due to premature closure of the sagittal suture. Evidence: TAS. Frequency: Very frequent (HP:0040281). (ORPHA:2477)
- Prominent occiput (HP:0000269): Increased convexity of the occiput (posterior part of the skull). Evidence: TAS. Frequency: Very frequent (HP:0040281). (ORPHA:2477)
- Pointed chin (HP:0000307): A marked tapering of the lower face to the chin. Evidence: TAS. Frequency: Very frequent (HP:0040281). (ORPHA:2477)
- Wide nasal bridge (HP:0000431): Increased breadth of the nasal bridge (and with it, the nasal root). Evidence: TAS. Frequency: Very frequent (HP:0040281). (ORPHA:2477)
- Short neck (HP:0000470): Diminished length of the neck. Evidence: TAS. Frequency: Very frequent (HP:0040281). (ORPHA:2477)
- Deeply set eye (HP:0000490): An eye that is more deeply recessed into the plane of the face than is typical. Evidence: TAS. Frequency: Very frequent (HP:0040281). (ORPHA:2477)
- Intellectual disability (HP:0001249): The term intellectual disability or intellectual developmental disorder is used to describe significantly sub-average intellectual and adaptive functioning based on clinical assessment and as measured by individually administered, appropriately normed, standardized and validated tests of intellectual functioning and adaptive behavior, with onset during the developmental period from infancy through adolescence. Evidence: TAS. Frequency: Very frequent (HP:0040281). (ORPHA:2477)
- Atrial septal defect (HP:0001631): Atrial septal defect (ASD) is a congenital abnormality of the interatrial septum that enables blood flow between the left and right atria via the interatrial septum. Evidence: TAS. Frequency: Frequent (HP:0040282). (ORPHA:2477)
- Truncal obesity (HP:0001956): Obesity located preferentially in the trunk of the body as opposed to the extremities. Evidence: TAS. Frequency: Very frequent (HP:0040281). (ORPHA:2477)
- Frontal bossing (HP:0002007): Bilateral bulging of the lateral frontal bone prominences with relative sparing of the midline. Evidence: TAS. Frequency: Very frequent (HP:0040281). (ORPHA:2477)
- Delayed skeletal maturation (HP:0002750): A decreased rate of skeletal maturation. Delayed skeletal maturation can be diagnosed on the basis of an estimation of the bone age from radiographs of specific bones in the human body. Evidence: TAS. Frequency: Very frequent (HP:0040281). (ORPHA:2477)
- Genu valgum (HP:0002857): The legs angle inward, such that the knees are close together and the ankles far apart. Evidence: TAS. Frequency: Frequent (HP:0040282). (ORPHA:2477)
These phenotypes are associated with the disease Isolated megalencephaly (ORPHA:2477).